Phenotypes associated with the disease Granular corneal dystrophy type I (ORPHA:98962):
- Corneal crystals (HP:0000531). Evidence: TAS. Frequency: Very frequent (HP:0040281). (ORPHA:98962)
- Central corneal dystrophy (HP:0007881). Evidence: TAS. Frequency: Very frequent (HP:0040281). (ORPHA:98962)
- Recurrent corneal erosions (HP:0000495): The presence of recurrent corneal epithelial erosions. Although most corneal epithelial defects heal quickly, some may show recurrent ulcerations. Evidence: TAS. Frequency: Frequent (HP:0040282). (ORPHA:98962)
- Visual impairment (HP:0000505): Visual impairment (or vision impairment) is vision loss (of a person) to such a degree as to qualify as an additional support need through a significant limitation of visual capability resulting from either disease, trauma, or congenital or degenerative conditions that cannot be corrected by conventional means, such as refractive correction, medication, or surgery. Evidence: TAS. Frequency: Frequent (HP:0040282). (ORPHA:98962)
- Central opacification of the cornea (HP:0011493): Reduced transparency of the central portion of the corneal stroma. Evidence: TAS. Frequency: Frequent (HP:0040282). (ORPHA:98962)
- Photophobia (HP:0000613): Excessive sensitivity to light with the sensation of discomfort or pain in the eyes due to exposure to bright light. Evidence: TAS. Frequency: Occasional (HP:0040283). (ORPHA:98962)
- Reduced visual acuity (HP:0007663). Evidence: TAS. Frequency: Occasional (HP:0040283). (ORPHA:98962)
- Subepithelial corneal opacities (HP:0008039). Evidence: TAS. Frequency: Occasional (HP:0040283). (ORPHA:98962)
- Abnormal corneal epithelium morphology (HP:0011495): Abnormality of the corneal epithelium, that is of the epithelial tissue that covers the front of the cornea. Evidence: TAS. Frequency: Occasional (HP:0040283). (ORPHA:98962)
- Ocular pain (HP:0200026): An unpleasant sensation characterized by physical discomfort (such as pricking, throbbing, or aching) localized to the eye. Evidence: TAS. Frequency: Occasional (HP:0040283). (ORPHA:98962)